- Brachycephaly (HP:0000248): An abnormality of skull shape characterized by a decreased anterior-posterior diameter. That is, a cephalic index greater than 81%. Alternatively, an apparently shortened anteroposterior dimension (length) of the head compared to width. Evidence: TAS. Frequency: Very frequent (HP:0040281). (ORPHA:35099)
- Hypertelorism (HP:0000316): Interpupillary distance more than 2 SD above the mean (alternatively, the appearance of an increased interpupillary distance or widely spaced eyes). Evidence: TAS. Frequency: Occasional (HP:0040283). (ORPHA:35099)
- Broad forehead (HP:0000337): Width of the forehead or distance between the frontotemporales is more than two standard deviations above the mean (objective); or apparently increased distance between the two sides of the forehead. Evidence: TAS. Frequency: Very frequent (HP:0040281). (ORPHA:35099)
- Hearing impairment (HP:0000365): A decreased magnitude of the sensory perception of sound. Evidence: TAS. Frequency: Frequent (HP:0040282). (ORPHA:35099)
- Proptosis (HP:0000520): An eye that is protruding anterior to the plane of the face to a greater extent than is typical. Evidence: TAS. Frequency: Frequent (HP:0040282). (ORPHA:35099)
- Brachydactyly (HP:0001156): Digits that appear disproportionately short compared to the hand/foot. The word brachydactyly is used here to describe a series distinct patterns of shortened digits (brachydactyly types A-E). This is the sense used here. Evidence: TAS. Frequency: Occasional (HP:0040283). (ORPHA:35099)
- Intellectual disability (HP:0001249): The term intellectual disability or intellectual developmental disorder is used to describe significantly sub-average intellectual and adaptive functioning based on clinical assessment and as measured by individually administered, appropriately normed, standardized and validated tests of intellectual functioning and adaptive behavior, with onset during the developmental period from infancy through adolescence. Evidence: TAS. Frequency: Occasional (HP:0040283). (ORPHA:35099)
- Increased intracranial pressure (HP:0002516): An increase of the pressure inside the cranium (skull) and thereby in the brain tissue and cerebrospinal fluid. Evidence: TAS. Frequency: Frequent (HP:0040282). (ORPHA:35099)
- Metacarpal synostosis (HP:0009701): Fusion involving two or more metacarpal bones (A synostosis of the first metacarpal and the proximal phalanx of the thumb can also be observed, note that the first metacarpal bone corresponds to a proximal phalanx). Evidence: TAS. Frequency: Occasional (HP:0040283). (ORPHA:35099)
- Underdeveloped supraorbital ridges (HP:0009891): Flatness of the supraorbital portion of the frontal bones. Evidence: TAS. Frequency: Frequent (HP:0040282). (ORPHA:35099)
- Midface retrusion (HP:0011800): Posterior positions and/or vertical shortening of the infraorbital and perialar regions, or increased concavity of the face and/or reduced nasolabial angle. Evidence: TAS. Frequency: Occasional (HP:0040283). (ORPHA:35099)
These phenotypes are associated with the disease Non-syndromic bicoronal craniosynostosis (ORPHA:35099).